Phenotypes associated with the disease varicose disease (OMIM:192200):
- Varicose veins (HP:0002619): Enlarged and tortuous veins. Evidence: IEA. (OMIM:192200)
- Non-Mendelian inheritance (HP:0001426): A mode of inheritance that depends on genetic determinants in more than one gene. Evidence: TAS. Frequency: 50%. (PMID:4435791)
- X-linked dominant inheritance (HP:0001423): A mode of inheritance that is observed for dominant traits related to a gene encoded on the X chromosome. In the context of medical genetics, X-linked dominant disorders tend to manifest very severely in affected males. The severity of manifestation in females may depend on the degree of skewed X inactivation. Evidence: TAS. (PMID:13561707)